Phenotypes associated with the disease nonsyndromic congenital nail disorder 6 (OMIM:107000):
- Congenital hip dislocation (HP:0001374). Evidence: IEA. (OMIM:107000)
- Nail dysplasia (HP:0002164): The presence of developmental dysplasia of the nail. Evidence: IEA. (OMIM:107000)
- Tapered distal phalanges of finger (HP:0009884): A reduction in diameter of the distal phalanx of finger towards the distal end. Evidence: TAS. Frequency: Occasional (HP:0040283). (OMIM:107000)
- Nail dystrophy (HP:0008404): Onychodystrophy (nail dystrophy) refers to nail changes apart from changes of the color (nail dyschromia) and involves partial or complete disruption of the various keratinous layers of the nail plate. Evidence: TAS. (OMIM:107000)
- Autosomal dominant inheritance (HP:0000006): A mode of inheritance that is observed for traits related to a gene encoded on one of the autosomes (i.e., the human chromosomes 1-22) in which a trait manifests in heterozygotes. In the context of medical genetics, an autosomal dominant disorder is caused when a single copy of the mutant allele is present. Males and females are affected equally, and can both transmit the disorder with a risk of 50% for each child of inheriting the mutant allele. Evidence: IEA. (OMIM:107000)
- Anonychia (HP:0001798): Aplasia of the nail. Evidence: IEA. (OMIM:107000)